Phenotypes associated with the disease leukodystrophy, hypomyelinating, 28 (OMIM:620978):
- Dysmetria (HP:0001310): A type of ataxia characterized by the inability to carry out movements with the correct range and motion across the plane of more than one joint related to incorrect estimation of the distances required for targeted movements. Evidence: PCS. Frequency: 1/1. (PMID:35217805)
- Seizure (HP:0001250): A seizure is an intermittent abnormality of nervous system physiology characterized by a transient occurrence of signs and/or symptoms due to abnormal excessive or synchronous neuronal activity in the brain. Evidence: PCS. Frequency: 1/2. (PMID:35217805)
- Global developmental delay (HP:0001263): A delay in the achievement of motor or mental milestones in the domains of development of a child, including motor skills, speech and language, cognitive skills, and social and emotional skills. This term should only be used to describe children younger than five years of age. Evidence: PCS. Frequency: 2/2. (PMID:35217805)
- Ataxia (HP:0001251): Ataxia refers to impaired coordination of voluntary muscle movement. Cerebellar ataxia refers to ataxia due to dysfunction of the cerebellum. This causes a variety of elementary neurological deficits including asynergy (lack of coordination between muscles, limbs and joints), dysmetria (lack of ability to judge distances that can lead to under- or overshoot in grasping movements), and dysdiadochokinesia (inability to perform rapid movements requiring antagonizing muscle groups to be switched on and off repeatedly). Evidence: PCS. Frequency: 1/1. (PMID:35217805)
- Infantile onset (HP:0003593): Onset of signs or symptoms of disease between 28 days to one year of life. Evidence: PCS. Frequency: 1/1. (PMID:35217805)
- Intention tremor (HP:0002080): A type of kinetic tremor that occurs during target directed movement is called intention tremor. That is, an oscillatory cerebellar ataxia that tends to be absent when the limbs are inactive and during the first part of voluntary movement but worsening as the movement continues and greater precision is required (e.g., in touching a target such as the patient's nose or a physician's finger). Evidence: PCS. Frequency: 1/1. (PMID:35217805)
- Nystagmus (HP:0000639): Rhythmic, involuntary oscillations of one or both eyes related to abnormality in fixation, conjugate gaze, or vestibular mechanisms. Evidence: PCS. Frequency: 2/2. (PMID:35217805)
- Motor regression (HP:0033044): Loss of previously achieved motor skills, as manifested by loss of developmental motor milestones. Evidence: PCS. Frequency: 2/2. (PMID:35217805)
- Cerebral dysmyelination (HP:0007266): Defective structure and function of myelin sheaths of the white matter of the brain. Evidence: PCS. Frequency: 1/1. (PMID:35217805)
- Autosomal recessive inheritance (HP:0000007): A mode of inheritance that is observed for traits related to a gene encoded on one of the autosomes (i.e., the human chromosomes 1-22) in which a trait manifests in individuals with two pathogenic alleles, either homozygotes (two copies of the same mutant allele) or compound heterozygotes (whereby each copy of a gene has a distinct mutant allele). Evidence: PCS. (PMID:35217805)
- Lower limb hypertonia (HP:0006895). Evidence: PCS. Frequency: 1/1. (PMID:35217805)
- Falls (HP:0002527). Evidence: PCS. Frequency: 2/2. (PMID:35217805)
- Brisk reflexes (HP:0001348): Tendon reflexes that are noticeably more active than usual (conventionally denoted 3+ on clinical examination). Brisk reflexes may or may not indicate a neurological lesion. They are distinguished from hyperreflexia by the fact that hyerreflexia is characterized by hyperactive repeating (clonic) reflexes, which are considered to be always abnormal. Evidence: PCS. Frequency: 1/1. (PMID:35217805)